Phenotypes associated with the disease metatarsus varus, type 1 (OMIM:156520):
- Metatarsus adductus (HP:0001840): The metatarsals are deviated medially (tibially), that is, the bones in the front half of the foot bend or turn in toward the body. Evidence: IEA. (OMIM:156520)
- Autosomal dominant inheritance (HP:0000006): A mode of inheritance that is observed for traits related to a gene encoded on one of the autosomes (i.e., the human chromosomes 1-22) in which a trait manifests in heterozygotes. In the context of medical genetics, an autosomal dominant disorder is caused when a single copy of the mutant allele is present. Males and females are affected equally, and can both transmit the disorder with a risk of 50% for each child of inheriting the mutant allele. Evidence: TAS. (OMIM:156520)